- Reduced antral follicle count (HP:0033085): A count of antral follicles that is lower than normal for age. Evidence: PCS. Frequency: 1/2. (PMID:32303603)
- Secondary amenorrhea (HP:0000869). Evidence: PCS. Frequency: 1/2. (PMID:32303603)
- Elevated circulating luteinizing hormone level (HP:0011969): An elevated concentration of luteinizing hormone in the blood. Evidence: PCS. Frequency: 1/2. (PMID:32303603)
- Female infertility (HP:0008222). Evidence: PCS. Frequency: 2/2. (PMID:32303603)
- Young adult onset (HP:0011462): Onset of disease at the age of between 16 and 40 years. Evidence: PCS. Frequency: 2/2. (PMID:32303603)
- Elevated circulating follicle stimulating hormone level (HP:0008232): An elevated concentration of follicle-stimulating hormone in the blood. Evidence: PCS. Frequency: 2/2. (PMID:32303603)
- Oligomenorrhea (HP:0000876): Infrequent menses (less than 6 per year or more than 35 days between cycles). Evidence: PCS. Frequency: 1/2. (PMID:32303603)
- Autosomal recessive inheritance (HP:0000007): A mode of inheritance that is observed for traits related to a gene encoded on one of the autosomes (i.e., the human chromosomes 1-22) in which a trait manifests in individuals with two pathogenic alleles, either homozygotes (two copies of the same mutant allele) or compound heterozygotes (whereby each copy of a gene has a distinct mutant allele). Evidence: PCS. (PMID:32303603)
- Decreased circulating antimullerian hormone circulation (HP:0031103): A reduction below the normal range of the antimullerian hormone in the circulation. Evidence: PCS. Frequency: 2/2. (PMID:32303603)
- Decreased serum estradiol (HP:0008214): A reduction below normal concentration of estradiol in the circulation. Evidence: PCS. Frequency: 1/2. (PMID:32303603)
These phenotypes are associated with the disease premature ovarian failure 24 (OMIM:620840).